Phenotypes associated with the disease Fetal hydantoin syndrome (ORPHA:1912):
- Hearing abnormality (HP:0000364): An abnormality of the sensory perception of sound. Evidence: TAS. Frequency: Very frequent (HP:0040281). (ORPHA:1912)
- Abnormal pinna morphology (HP:0000377): An abnormality of the pinna, which is also referred to as the auricle or external ear. Evidence: TAS. Frequency: Very frequent (HP:0040281). (ORPHA:1912)
- Depressed nasal ridge (HP:0000457): Lack of prominence of the nose resulting from a posteriorly-placed nasal ridge. Evidence: TAS. Frequency: Very frequent (HP:0040281). (ORPHA:1912)
- Short nose (HP:0003196): Distance from nasion to subnasale more than two standard deviations below the mean, or alternatively, an apparently decreased length from the nasal root to the nasal tip. Evidence: TAS. Frequency: Very frequent (HP:0040281). (ORPHA:1912)
- Abnormal dermatoglyphics (HP:0007477): An abnormality of dermatoglyphs (fingerprints), which are present on fingers, palms, toes, and soles. Evidence: TAS. Frequency: Very frequent (HP:0040281). (ORPHA:1912)
- Bifid scrotum (HP:0000048): Midline indentation or cleft of the scrotum. Evidence: TAS. Frequency: Frequent (HP:0040282). (ORPHA:1912)
- Wide mouth (HP:0000154): Distance between the oral commissures more than 2 SD above the mean. Alternatively, an apparently increased width of the oral aperture (subjective). Evidence: TAS. Frequency: Frequent (HP:0040282). (ORPHA:1912)
- Everted lower lip vermilion (HP:0000232): An abnormal configuration of the lower lip such that it is turned outward i.e., everted, with the Inner aspect of the lower lip vermilion (normally opposing the teeth) being visible in a frontal view. Evidence: TAS. Frequency: Frequent (HP:0040282). (ORPHA:1912)
- Abnormal cranial suture/fontanelle morphology (HP:0000235): Any abnormality of the fontanelles (the regions covered by a thick membrane that normally ossify in the first two years of life) or the cranial sutures (the fibrous joints in which the articulating bones or cartilages of the skull are connected by sutural ligaments). Evidence: TAS. Frequency: Frequent (HP:0040282). (ORPHA:1912)
- Microcephaly (HP:0000252): Head circumference below 2 standard deviations below the mean for age and gender. Evidence: TAS. Frequency: Frequent (HP:0040282). (ORPHA:1912)
- Epicanthus (HP:0000286): A fold of skin starting above the medial aspect of the upper eyelid and arching downward to cover, pass in front of and lateral to the medial canthus. Evidence: TAS. Frequency: Frequent (HP:0040282). (ORPHA:1912)
- Hypertelorism (HP:0000316): Interpupillary distance more than 2 SD above the mean (alternatively, the appearance of an increased interpupillary distance or widely spaced eyes). Evidence: TAS. Frequency: Frequent (HP:0040282). (ORPHA:1912)
- Thickened nuchal skin fold (HP:0000474): A thickening of the skin thickness in the posterior aspect of the fetal neck. A nuchal fold (NF) measurement is obtained in a transverse section of the fetal head at the level of the cavum septum pellucidum and thalami, angled posteriorly to include the cerebellum. The measurement is taken from the outer edge of the occiput bone to the outer skin limit directly in the midline. An NF measurement greater than 5 mm at 14 to 17+6 weeks of gestation, or 6 mm at 18 to 28 weeks has been associated with a markedly increased risk for Down syndrome. Evidence: TAS. Frequency: Frequent (HP:0040282). (ORPHA:1912)
- Strabismus (HP:0000486): A misalignment of the eyes so that the visual axes deviate from bifoveal fixation. The classification of strabismus may be based on a number of features including the relative position of the eyes, whether the deviation is latent or manifest, intermittent or constant, concomitant or otherwise and according to the age of onset and the relevance of any associated refractive error. Evidence: TAS. Frequency: Frequent (HP:0040282). (ORPHA:1912)
- Ptosis (HP:0000508): The upper eyelid margin is positioned 3 mm or more lower than usual and covers the superior portion of the iris (objective); or, the upper lid margin obscures at least part of the pupil (subjective). Evidence: TAS. Frequency: Frequent (HP:0040282). (ORPHA:1912)
- Triphalangeal thumb (HP:0001199): A thumb with three phalanges in a single, proximo-distal axis. Thus, this term applies if the thumb has an accessory phalanx, leading to a digit like appearance of the thumb. Evidence: TAS. Frequency: Frequent (HP:0040282). (ORPHA:1912)
- Global developmental delay (HP:0001263): A delay in the achievement of motor or mental milestones in the domains of development of a child, including motor skills, speech and language, cognitive skills, and social and emotional skills. This term should only be used to describe children younger than five years of age. Evidence: TAS. Frequency: Frequent (HP:0040282). (ORPHA:1912)
- Intrauterine growth retardation (HP:0001511): An abnormal restriction of fetal growth with fetal weight below the tenth percentile for gestational age. Evidence: TAS. Frequency: Frequent (HP:0040282). (ORPHA:1912)
- Hypoplastic fingernail (HP:0001804): Underdevelopment of a fingernail. Evidence: TAS. Frequency: Frequent (HP:0040282). (ORPHA:1912)
- Low posterior hairline (HP:0002162): Hair on the neck extends more inferiorly than usual. Evidence: TAS. Frequency: Frequent (HP:0040282). (ORPHA:1912)
- Coarse hair (HP:0002208): Hair shafts are rough in texture. Evidence: TAS. Frequency: Frequent (HP:0040282). (ORPHA:1912)
- Short stature (HP:0004322): A height below that which is expected according to age and gender norms. Although there is no universally accepted definition of short stature, many refer to "short stature" as height more than 2 standard deviations below the mean for age and gender (or below the 3rd percentile for age and gender dependent norms). Evidence: TAS. Frequency: Frequent (HP:0040282). (ORPHA:1912)
- Wide intermamillary distance (HP:0006610): A larger than usual distance between the left and right nipple. Evidence: TAS. Frequency: Frequent (HP:0040282). (ORPHA:1912)
- Short distal phalanx of finger (HP:0009882): Short distance from the end of the finger to the most distal interphalangeal crease or the distal interphalangeal joint flexion point. That is, hypoplasia of one or more of the distal phalanx of finger. Evidence: TAS. Frequency: Frequent (HP:0040282). (ORPHA:1912)
- Hernia (HP:0100790). Evidence: TAS. Frequency: Frequent (HP:0040282). (ORPHA:1912)
- Cryptorchidism (HP:0000028): Testis in inguinal canal. That is, absence of one or both testes from the scrotum owing to failure of the testis or testes to descend through the inguinal canal to the scrotum. Evidence: TAS. Frequency: Occasional (HP:0040283). (ORPHA:1912)
- Cleft palate (HP:0000175): Cleft palate is a developmental defect of the palate resulting from a failure of fusion of the palatine processes and manifesting as a separation of the roof of the mouth (soft and hard palate). Evidence: TAS. Frequency: Occasional (HP:0040283). (ORPHA:1912)
- Abnormality of the cardiovascular system (HP:0001626): Any abnormality of the cardiovascular system. Evidence: TAS. Frequency: Occasional (HP:0040283). (ORPHA:1912)
- Neoplasm (HP:0002664): An organ or organ-system abnormality that consists of uncontrolled autonomous cell-proliferation which can occur in any part of the body as a benign or malignant neoplasm (tumor). Evidence: TAS. Frequency: Occasional (HP:0040283). (ORPHA:1912)
- Posteriorly rotated ears (HP:0000358): A type of abnormal location of the ears in which the position of the ears is characterized by posterior rotation (the superior part of the ears is rotated towards the back of the head, and the inferior part of the ears towards the front). Evidence: TAS. Frequency: Very frequent (HP:0040281). (ORPHA:1912)